Phenotypes associated with the disease immunodeficiency 128 (OMIM:620983):
- Decreased total T cell count (HP:0005403): Abnormal decrease in the absolute number of T cells, commonly characterized as CD3+ lymphocytes, per microliter of blood, compared to a reference range for a given sex and age-group. These may include both TCR alpha/beta and gamma/delta T cells. Evidence: PCS. Frequency: 5/5. (PMID:33529166)
- Abnormal memory T cell proportion (HP:0032182): An abnormal proportion of memory T cells compared to the total number of T cells in the blood. Memory T cells have previously encountered and responded to their cognate antigen and upon a repeated encounter with the antigen can mount a faster and stronger response. Evidence: PCS. Frequency: 0/5. (PMID:33529166)
- Decreased anti-CD3/28-induced T-cell proliferation (HP:0031382): Abnormal decrease of T cell proliferation in response to anti-CD3/28 stimulation. This is commonly measured through intracellular expression of Ki67, decreasing surface expression of carboxyfluorescein diacetate (CFSE), or 3H-thymidine incorporation. Length of incubation and strength of stimulation may vary between laboratories. Evidence: PCS. Frequency: 4/4. (PMID:33529166)
- Abnormal naive T cell proportion (HP:0031396): Any abnormality in the proportion of naive T cells relative to the total number of T cells. Evidence: PCS. Frequency: 0/5. (PMID:33529166)
- Infantile onset (HP:0003593): Onset of signs or symptoms of disease between 28 days to one year of life. Evidence: PCS. Frequency: 5/5. (PMID:33529166)
- Impaired phytohemagglutinin-induced T lymphocyte transformation (HP:0025834): Def: A reduced rate of T lymphocyte transformation in response to in vitro stimulation to the mitogen phytohemagglutinin (PHA). Following PHA stimulation, T cells normally undergo morphological and biochemical alterations that reflect the transformation into lymphoblasts. There are several methods for quantifying this effect including measuring the uptake of the radioactive marker 3H-TdR, methyl thiazolyl tetrazolium colorimetric analysis (MTT assay), and morphological examination under the microscope or using a hematology analyzer. Various types of stimulation index compare the amount of proliferation between treated and control cells. An impaired test refers to a result in which the amount of stimulation is subnormal. Evidence: PCS. Frequency: 4/4. (PMID:33529166)
- Abnormal gamma-delta T cell proportion (HP:0500269): Abnormal increase or decrease of TCR gamma/delta positive T cells, measured as percentage of total CD3+ T cells in the blood, compared to a reference range for a given sex and age-group. Evidence: PCS. Frequency: 0/4. (PMID:33529166)
- Autosomal recessive inheritance (HP:0000007): A mode of inheritance that is observed for traits related to a gene encoded on one of the autosomes (i.e., the human chromosomes 1-22) in which a trait manifests in individuals with two pathogenic alleles, either homozygotes (two copies of the same mutant allele) or compound heterozygotes (whereby each copy of a gene has a distinct mutant allele). Evidence: PCS. (PMID:33529166)
- Decreased total B cell count (HP:0010976): The absolute number of B cells in the blood, per microlitre is below the lower limit of normal of the reference range for the appropriate sex and age-group. Evidence: PCS. Frequency: 3/5. (PMID:33529166)
- Reduced total natural killer cell count (HP:0040218): The absolute count of natural killer cells in the blood, per microlitre, is below the lower limit of normal. Evidence: PCS. Frequency: 3/5. (PMID:33529166)
- Decreased total CD4+ T cell proportion (HP:0032218): Abnormal decrease of helper CD3+CD4+ T cells, measured as percentage of total CD3+ T cells in the blood, compared to a reference range for a given sex and age-group. These are usually measured within the TCR alpha/beta positive population. Evidence: PCS. Frequency: 5/5. (PMID:33529166)
- Decreased total CD8+ T cell proportion (HP:0005415): Abnormal decrease of cytotoxic CD3+CD8+ T cells, measured as percentage of total CD3+ T cells in the blood, compared to a reference range for a given sex and age-group. These are usually measured within the TCR alpha/beta positive population. Evidence: PCS. Frequency: 3/5. (PMID:33529166)